- Sensorineural hearing impairment (HP:0000407): A type of hearing impairment in one or both ears related to an abnormal functionality of the cochlear nerve. Evidence: TAS. (OMIM:601316)
- Autosomal dominant inheritance (HP:0000006): A mode of inheritance that is observed for traits related to a gene encoded on one of the autosomes (i.e., the human chromosomes 1-22) in which a trait manifests in heterozygotes. In the context of medical genetics, an autosomal dominant disorder is caused when a single copy of the mutant allele is present. Males and females are affected equally, and can both transmit the disorder with a risk of 50% for each child of inheriting the mutant allele. Evidence: TAS. (OMIM:601316)
These phenotypes are associated with the disease autosomal dominant nonsyndromic hearing loss 10 (OMIM:601316).